Phenotypes associated with the disease Uveal coloboma-cleft lip and palate-intellectual disability (ORPHA:1473):
- Sensorineural hearing impairment (HP:0000407): A type of hearing impairment in one or both ears related to an abnormal functionality of the cochlear nerve. Evidence: TAS. Frequency: Very frequent (HP:0040281). (ORPHA:1473)
- Chorioretinal coloboma (HP:0000567): Absence of a region of the retina, retinal pigment epithelium, and choroid. Evidence: TAS. Frequency: Very frequent (HP:0040281). (ORPHA:1473)
- Microphthalmia (HP:0000568): A developmental anomaly characterized by abnormal smallness of one or both eyes. Evidence: TAS. Frequency: Frequent (HP:0040282). (ORPHA:1473)
- Iris coloboma (HP:0000612): A coloboma of the iris. Evidence: TAS. Frequency: Frequent (HP:0040282). (ORPHA:1473)
- Hematuria (HP:0000790): The presence of blood in the urine. Hematuria may be gross hematuria (visible to the naked eye) or microscopic hematuria (detected by dipstick or microscopic examination of the urine). Evidence: TAS. Frequency: Frequent (HP:0040282). (ORPHA:1473)
- Intellectual disability (HP:0001249): The term intellectual disability or intellectual developmental disorder is used to describe significantly sub-average intellectual and adaptive functioning based on clinical assessment and as measured by individually administered, appropriately normed, standardized and validated tests of intellectual functioning and adaptive behavior, with onset during the developmental period from infancy through adolescence. Evidence: TAS. Frequency: Frequent (HP:0040282). (ORPHA:1473)
- Strabismus (HP:0000486): A misalignment of the eyes so that the visual axes deviate from bifoveal fixation. The classification of strabismus may be based on a number of features including the relative position of the eyes, whether the deviation is latent or manifest, intermittent or constant, concomitant or otherwise and according to the age of onset and the relevance of any associated refractive error. Evidence: TAS. Frequency: Occasional (HP:0040283). (ORPHA:1473)
- Glaucoma (HP:0000501): Glaucoma refers loss of retinal ganglion cells in a characteristic pattern of optic neuropathy usually associated with increased intraocular pressure. Evidence: TAS. Frequency: Occasional (HP:0040283). (ORPHA:1473)
- Visual impairment (HP:0000505): Visual impairment (or vision impairment) is vision loss (of a person) to such a degree as to qualify as an additional support need through a significant limitation of visual capability resulting from either disease, trauma, or congenital or degenerative conditions that cannot be corrected by conventional means, such as refractive correction, medication, or surgery. Evidence: TAS. Frequency: Occasional (HP:0040283). (ORPHA:1473)
- Ptosis (HP:0000508): The upper eyelid margin is positioned 3 mm or more lower than usual and covers the superior portion of the iris (objective); or, the upper lid margin obscures at least part of the pupil (subjective). Evidence: TAS. Frequency: Occasional (HP:0040283). (ORPHA:1473)
- Cataract (HP:0000518): A cataract is an opacity or clouding that develops in the crystalline lens of the eye or in its capsule. Evidence: TAS. Frequency: Occasional (HP:0040283). (ORPHA:1473)
- Retinal detachment (HP:0000541): Separation of the inner layers of the retina (neural retina) from the pigment epithelium. Evidence: TAS. Frequency: Occasional (HP:0040283). (ORPHA:1473)
- Posterior embryotoxon (HP:0000627): A posterior embryotoxon is the presence of a prominent and anteriorly displaced line of Schwalbe. Evidence: TAS. Frequency: Occasional (HP:0040283). (ORPHA:1473)
- Nystagmus (HP:0000639): Rhythmic, involuntary oscillations of one or both eyes related to abnormality in fixation, conjugate gaze, or vestibular mechanisms. Evidence: TAS. Frequency: Occasional (HP:0040283). (ORPHA:1473)
- Optic atrophy (HP:0000648): Atrophy of the optic nerve. Optic atrophy results from the death of the retinal ganglion cell axons that comprise the optic nerve and manifesting as a pale optic nerve on fundoscopy. Evidence: TAS. Frequency: Occasional (HP:0040283). (ORPHA:1473)
- Corneal opacity (HP:0007957): A reduction of corneal clarity. Evidence: TAS. Frequency: Occasional (HP:0040283). (ORPHA:1473)